Phenotypes associated with the disease myeloproliferative disorder, chronic, with eosinophilia (OMIM:131440):
- Increased total eosinophil count (HP:0001880): Increased count of eosinophils in the blood. Evidence: IEA. (OMIM:131440)
- Malignant eosinophil proliferation (HP:0006782). Evidence: TAS. (OMIM:131440)
- Autosomal dominant inheritance (HP:0000006): A mode of inheritance that is observed for traits related to a gene encoded on one of the autosomes (i.e., the human chromosomes 1-22) in which a trait manifests in heterozygotes. In the context of medical genetics, an autosomal dominant disorder is caused when a single copy of the mutant allele is present. Males and females are affected equally, and can both transmit the disorder with a risk of 50% for each child of inheriting the mutant allele. Evidence: TAS. (OMIM:131440)
- Myeloproliferative disorder (HP:0005547): Proliferation (excess production) of hemopoietically active tissue or of tissue which has embryonic hemopoietic potential. Evidence: TAS. (OMIM:131440)